Phenotypes associated with the disease abdominal obesity-metabolic syndrome 4 (OMIM:618620):
- Decreased circulating HDL-C concentration (HP:0003233): The concentration of high-density lipoprotein cholesterol in the blood circulation is below the lower limit of normal. Evidence: PCS. Frequency: 9/17. (PMID:31358993)
- Hypertriglyceridemia (HP:0002155): An abnormal increase in the level of triglycerides in the blood. Evidence: PCS. Frequency: 10/17. (PMID:31358993)
- Elevated circulating LDL-C concentration (HP:0003141): The concentration of low-density lipoprotein cholesterol in the blood circulation is above the upper limit of normal. Evidence: PCS. Frequency: 5/16. (PMID:31358993)
- Hypertension (HP:0000822): The presence of chronic increased pressure in the systemic arterial system. Evidence: PCS. Frequency: 26/35. (PMID:31358993)
- Myocardial infarction (HP:0001658): Necrosis of the myocardium caused by an obstruction of the blood supply to the heart and often associated with chest pain, shortness of breath, palpitations, and anxiety as well as characteristic EKG findings and elevation of serum markers including creatine kinase-MB fraction and troponin. Evidence: PCS. Frequency: 13/36. (PMID:31358993)
- Elevated hemoglobin A1c (HP:0040217): An increased concentration of hemoglobin A1c (HbA1c), which is the product of nonenzymatic attachment of a hexose molecule to the N-terminal amino acid of the hemoglobin molecule. This reaction is dependent on blood glucose concentration, and therefore reflects the mean glucose concentration over the previous 8 to 12 weeks. The HbA1c level provides a better indication of long-term glycemic control than one-time blood or urinary glucose measurements. Evidence: PCS. Frequency: 7/17. (PMID:31358993)
- Type II diabetes mellitus (HP:0005978): A type of diabetes mellitus initially characterized by insulin resistance and hyperinsulinemia and subsequently by glucose interolerance and hyperglycemia. Evidence: PCS. (PMID:31358993)
- Autosomal dominant inheritance (HP:0000006): A mode of inheritance that is observed for traits related to a gene encoded on one of the autosomes (i.e., the human chromosomes 1-22) in which a trait manifests in heterozygotes. In the context of medical genetics, an autosomal dominant disorder is caused when a single copy of the mutant allele is present. Males and females are affected equally, and can both transmit the disorder with a risk of 50% for each child of inheriting the mutant allele. Evidence: PCS. (PMID:31358993)
- Accelerated atherosclerosis (HP:0004943): Atherosclerosis which occurs in a person with certain risk factors (e.g., SLE, diabetes, smoking, hypertension, hypercholesterolaemia, family history of early heart disease) at an earlier age than would occur in another person without those risk factors. Evidence: PCS. (PMID:31358993)
- Obesity (HP:0001513): Accumulation of substantial excess body fat. Evidence: PCS. (PMID:31358993)
- Coronary artery atherosclerosis (HP:0001677): Reduction of the diameter of the coronary arteries as the result of an accumulation of atheromatous plaques within the walls of the coronary arteries, which increases the risk of myocardial ischemia. Evidence: PCS. (PMID:31358993)